- Autosomal dominant inheritance (HP:0000006): A mode of inheritance that is observed for traits related to a gene encoded on one of the autosomes (i.e., the human chromosomes 1-22) in which a trait manifests in heterozygotes. In the context of medical genetics, an autosomal dominant disorder is caused when a single copy of the mutant allele is present. Males and females are affected equally, and can both transmit the disorder with a risk of 50% for each child of inheriting the mutant allele. Evidence: IEA. (OMIM:190800)
- Three rows of eyelashes (HP:0008009). Evidence: IEA. (OMIM:190800)
These phenotypes are associated with the disease Tristichiasis (OMIM:190800).